Phenotypes associated with the disease Middle ear neuroendocrine tumor (ORPHA:100084):
- Carcinoid tumor (HP:0100570): A tumor formed from the endocrine (argentaffin) cells of the mucosal lining of a variety of organs including the stomach and intestine. These cells are from neuroectodermal origin. Evidence: TAS. Frequency: Obligate (HP:0040280). (ORPHA:100084)
- Neuroendocrine neoplasm (HP:0100634): A tumor that originates from a neuroendocrine cell. Evidence: TAS. Frequency: Obligate (HP:0040280). (ORPHA:100084)
- Unilateral conductive hearing impairment (HP:0040119). Evidence: TAS. Frequency: Very frequent (HP:0040281). (ORPHA:100084)
- Abnormal tympanic membrane morphology (HP:0040090): Any structural abnormality of the tympanic membrane. Evidence: TAS. Frequency: Frequent (HP:0040282). (ORPHA:100084)
- Tinnitus (HP:0000360): Tinnitus is an auditory perception that can be described as the experience of sound, in the ear or in the head, in the absence of external acoustic stimulation. Evidence: TAS. Frequency: Occasional (HP:0040283). (ORPHA:100084)
- Abnormal auditory canal morphology (HP:0000372): Any structural abnormality of the external acoustic tube (also known as the auditory canal). Evidence: TAS. Frequency: Occasional (HP:0040283). (ORPHA:100084)
- Sensorineural hearing impairment (HP:0000407): A type of hearing impairment in one or both ears related to an abnormal functionality of the cochlear nerve. Evidence: TAS. Frequency: Occasional (HP:0040283). (ORPHA:100084)
- Chronic noninfectious lymphadenopathy (HP:0002730): A chronic form of lymphadenopathy that is not related to infection. Evidence: TAS. Frequency: Occasional (HP:0040283). (ORPHA:100084)
- Chronic diarrhea (HP:0002028): The presence of chronic diarrhea, which is usually taken to mean diarrhea that has persisted for over 4 weeks. Evidence: TAS. Frequency: Very rare (HP:0040284). (ORPHA:100084)
- Headache (HP:0002315): Cephalgia, or pain sensed in various parts of the head, not confined to the area of distribution of any nerve. Evidence: TAS. Frequency: Very rare (HP:0040284). (ORPHA:100084)
- Facial palsy (HP:0010628): Facial nerve palsy is a dysfunction of cranial nerve VII (the facial nerve) that results in inability to control facial muscles on the affected side with weakness of the muscles of facial expression and eye closure. This can either be present in unilateral or bilateral form. Evidence: TAS. Frequency: Very rare (HP:0040284). (ORPHA:100084)